Phenotypes associated with the disease Pituitary gigantism (ORPHA:99725):
- Tall stature (HP:0000098): A height above that which is expected according to age and gender norms. Evidence: TAS. Frequency: Very frequent (HP:0040281). (ORPHA:99725)
- Amenorrhea (HP:0000141): Absence of menses for an interval of time equivalent to a total of more than (or equal to) 3 previous cycles or 6 months. Evidence: TAS. Frequency: Frequent (HP:0040282). (ORPHA:99725)
- Coarse facial features (HP:0000280): Absence of fine and sharp appearance of brows, nose, lips, mouth, and chin, usually because of rounded and heavy features or thickened skin with or without thickening of subcutaneous and bony tissues. Evidence: TAS. Frequency: Very frequent (HP:0040281). (ORPHA:99725)
- Mandibular prognathia (HP:0000303): Abnormal prominence of the chin related to increased length of the mandible. Evidence: TAS. Frequency: Very frequent (HP:0040281). (ORPHA:99725)
- Increased circulating prolactin concentration (HP:0000870): The presence of abnormally increased levels of prolactin in the blood. Prolactin is a peptide hormone produced by the anterior pituitary gland that plays a role in breast development and lactation during pregnancy. Evidence: TAS. Frequency: Frequent (HP:0040282). (ORPHA:99725)
- Elevated circulating growth hormone concentration (HP:0000845): Acromegaly is a condition resulting from overproduction of growth hormone by the pituitary gland in persons with closed epiphyses, and consists chiefly in the enlargement of the distal parts of the body. The circumference of the skull increases, the nose becomes broad, the tongue becomes enlarged, the facial features become coarsened, the mandible grows excessively, and the teeth become separated. The fingers and toes grow chiefly in thickness. Evidence: TAS. Frequency: Very frequent (HP:0040281). (ORPHA:99725)
- Hyperhidrosis (HP:0000975): Abnormal excessive perspiration (sweating) despite the lack of appropriate stimuli like hot and humid weather. Evidence: TAS. Frequency: Very frequent (HP:0040281). (ORPHA:99725)
- Large hands (HP:0001176). Evidence: TAS. Frequency: Very frequent (HP:0040281). (ORPHA:99725)
- Hypertrophic cardiomyopathy (HP:0001639): Hypertrophic cardiomyopathy (HCM) is defined by the presence of increased ventricular wall thickness or mass in the absence of loading conditions (hypertension, valve disease) sufficient to cause the observed abnormality. Evidence: TAS. Frequency: Very frequent (HP:0040281). (ORPHA:99725)
- Left ventricular hypertrophy (HP:0001712): Enlargement or increased size of the heart left ventricle. Evidence: TAS. Frequency: Very frequent (HP:0040281). (ORPHA:99725)
- Long foot (HP:0001833): Increased back to front length of the foot. Evidence: TAS. Frequency: Very frequent (HP:0040281). (ORPHA:99725)
- Frontal bossing (HP:0002007): Bilateral bulging of the lateral frontal bone prominences with relative sparing of the midline. Evidence: TAS. Frequency: Very frequent (HP:0040281). (ORPHA:99725)
- Accelerated skeletal maturation (HP:0005616): An abnormally increased rate of skeletal maturation. Accelerated skeletal maturation can be diagnosed on the basis of an estimation of the bone age from radiographs of specific bones in the human body. Evidence: TAS. Frequency: Very frequent (HP:0040281). (ORPHA:99725)
- Type II diabetes mellitus (HP:0005978): A type of diabetes mellitus initially characterized by insulin resistance and hyperinsulinemia and subsequently by glucose interolerance and hyperglycemia. Evidence: TAS. Frequency: Very frequent (HP:0040281). (ORPHA:99725)
- Pituitary prolactin cell adenoma (HP:0006767): A type of pituitary adenoma originating in prolactin secreting cells. This kind of adenoma is characterized by overproduction of prolactin, and may cause loss of menstrual periods and breast milk production in women. Evidence: TAS. Frequency: Frequent (HP:0040282). (ORPHA:99725)
- Proportionate tall stature (HP:0011407). Evidence: TAS. Frequency: Very frequent (HP:0040281). (ORPHA:99725)
- Pituitary growth hormone cell adenoma (HP:0011760): A type of pituitary adenoma that produces growth hormone. Evidence: TAS. Frequency: Very frequent (HP:0040281). (ORPHA:99725)
- Premature pubarche (HP:0012411): The onset of growth of pubic hair at an earlier age than normal. Evidence: TAS. Frequency: Very frequent (HP:0040281). (ORPHA:99725)
- Increased circulating insulin-like growth factor 1 concentration (HP:0030269): The concentration of insulin-like growth factor 1 (IGF1) in the blood circulation is above the upper limit of normal. Evidence: TAS. Frequency: Very frequent (HP:0040281). (ORPHA:99725)
- Galactorrhea (HP:0100829): Spontaneous flow of milk from the breast, unassociated with childbirth or nursing. Evidence: TAS. Frequency: Occasional (HP:0040283). (ORPHA:99725)